- Mild intellectual disability (HP:0001256): Mild intellectual disability (ID) is defined as a type of ID characterized by mildly sub-average adaptive functioning and intellectual functioning, with an intelligence quotient (IQ) the range of 50-69. Evidence: IEA. Frequency: 1/5. (OMIM:276710)
- Seizure (HP:0001250): A seizure is an intermittent abnormality of nervous system physiology characterized by a transient occurrence of signs and/or symptoms due to abnormal excessive or synchronous neuronal activity in the brain. Evidence: PCS. Frequency: 0/5. (PMID:10942115)
- Hypertyrosinemia (HP:0003231): An increased concentration of tyrosine in the blood. Evidence: PCS. Frequency: 5/5. (PMID:10942115)
- Global developmental delay (HP:0001263): A delay in the achievement of motor or mental milestones in the domains of development of a child, including motor skills, speech and language, cognitive skills, and social and emotional skills. This term should only be used to describe children younger than five years of age. Evidence: PCS. Frequency: 3/5. (PMID:10942115)
- Infantile onset (HP:0003593): Onset of signs or symptoms of disease between 28 days to one year of life. Evidence: PCS. Frequency: 1/3. (PMID:10942115)
- 4-Hydroxyphenylpyruvic aciduria (HP:0003161): Increased relative concentration of 4-hydroxyphenylpyruvic acid in the urine. Evidence: PCS. Frequency: 4/4. (PMID:10942115)
- Autosomal recessive inheritance (HP:0000007): A mode of inheritance that is observed for traits related to a gene encoded on one of the autosomes (i.e., the human chromosomes 1-22) in which a trait manifests in individuals with two pathogenic alleles, either homozygotes (two copies of the same mutant allele) or compound heterozygotes (whereby each copy of a gene has a distinct mutant allele). Evidence: PCS. (PMID:10942115)
- 4-hydroxyphenylacetic aciduria (HP:0003607): Increased concentration of 4-hydroxyphenylacetic acid in the urine. Evidence: PCS. Frequency: 4/4. (PMID:10942115)
- Elevated circulating hepatic transaminase concentration (HP:0002910): Elevations of the levels of SGOT and SGPT in the serum. SGOT (serum glutamic oxaloacetic transaminase) and SGPT (serum glutamic pyruvic transaminase) are transaminases primarily found in the liver and heart and are released into the bloodstream as the result of liver or heart damage. SGOT and SGPT are used clinically mainly as markers of liver damage. Evidence: PCS. Frequency: 0/5. (PMID:10942115)
- Severe intellectual disability (HP:0010864): Severe intellectual disability (ID) is defined as a type of ID characterized by severely sub-average adaptive functioning and intellectual functioning, with an intelligence quotient (IQ) the range of 20-34. Evidence: PCS. Frequency: 1/5. (PMID:10942115)
- Neonatal onset (HP:0003623): Onset of signs or symptoms of disease within the first 28 days of life. Evidence: PCS. Frequency: 2/3. (PMID:10942115)
These phenotypes are associated with the disease tyrosinemia type III (OMIM:276710).